- Corneal opacity (HP:0007957): A reduction of corneal clarity. Evidence: TAS. (OMIM:304730)
- X-linked inheritance (HP:0001417): A mode of inheritance that is observed for traits related to a gene encoded on the X chromosome. Evidence: IEA. (OMIM:304730)
- Abnormality of the eye (HP:0000478): Any abnormality of the eye, including location, spacing, and intraocular abnormalities. Evidence: IEA. (OMIM:304730)
These phenotypes are associated with the disease X-linked corneal dermoid (OMIM:304730).